- Macrocephaly (HP:0000256): Occipitofrontal (head) circumference greater than 97th centile compared to appropriate, age matched, sex-matched normal standards. Alternatively, a apparently increased size of the cranium. Evidence: TAS. Frequency: Very frequent (HP:0040281). (ORPHA:357001)
- Abnormal facial shape (HP:0001999): An abnormal morphology (form) of the face or its components. Evidence: TAS. Frequency: Very frequent (HP:0040281). (ORPHA:357001)
- Prominent forehead (HP:0011220): Forward prominence of the entire forehead, due to protrusion of the frontal bone. Evidence: TAS. Frequency: Very frequent (HP:0040281). (ORPHA:357001)
- Long face (HP:0000276): Facial height (length) is more than 2 standard deviations above the mean (objective); or, an apparent increase in the height (length) of the face (subjective). Evidence: TAS. Frequency: Frequent (HP:0040282). (ORPHA:357001)
- Anteverted nares (HP:0000463): Anteriorly-facing nostrils viewed with the head in the Frankfurt horizontal and the eyes of the observer level with the eyes of the subject. This gives the appearance of an upturned nose (upturned nasal tip). Evidence: TAS. Frequency: Frequent (HP:0040282). (ORPHA:357001)
- Strabismus (HP:0000486): A misalignment of the eyes so that the visual axes deviate from bifoveal fixation. The classification of strabismus may be based on a number of features including the relative position of the eyes, whether the deviation is latent or manifest, intermittent or constant, concomitant or otherwise and according to the age of onset and the relevance of any associated refractive error. Evidence: TAS. Frequency: Frequent (HP:0040282). (ORPHA:357001)
- Downslanted palpebral fissures (HP:0000494): The palpebral fissure inclination is more than two standard deviations below the mean. Evidence: TAS. Frequency: Frequent (HP:0040282). (ORPHA:357001)
- Pectus excavatum (HP:0000767): A defect of the chest wall characterized by a depression of the sternum, giving the chest ("pectus") a caved-in ("excavatum") appearance. Evidence: TAS. Frequency: Frequent (HP:0040282). (ORPHA:357001)
- Intellectual disability (HP:0001249): The term intellectual disability or intellectual developmental disorder is used to describe significantly sub-average intellectual and adaptive functioning based on clinical assessment and as measured by individually administered, appropriately normed, standardized and validated tests of intellectual functioning and adaptive behavior, with onset during the developmental period from infancy through adolescence. Evidence: TAS. Frequency: Frequent (HP:0040282). (ORPHA:357001)
- Global developmental delay (HP:0001263): A delay in the achievement of motor or mental milestones in the domains of development of a child, including motor skills, speech and language, cognitive skills, and social and emotional skills. This term should only be used to describe children younger than five years of age. Evidence: TAS. Frequency: Frequent (HP:0040282). (ORPHA:357001)
- Attention deficit hyperactivity disorder (HP:0007018): Attention deficit hyperactivity disorder (ADHD) manifests at age 2-3 years or by first grade at the latest. The main symptoms are distractibility, impulsivity, hyperactivity, and often trouble organizing tasks and projects, difficulty going to sleep, and social problems from being aggressive, loud, or impatient. Evidence: TAS. Frequency: Frequent (HP:0040282). (ORPHA:357001)
- Functional abnormality of the gastrointestinal tract (HP:0012719): Abnormal functionality of the gastrointestinal tract. Evidence: TAS. Frequency: Frequent (HP:0040282). (ORPHA:357001)
- Macroglossia (HP:0000158): Increased length and width of the tongue. Evidence: TAS. Frequency: Occasional (HP:0040283). (ORPHA:357001)
- Narrow mouth (HP:0000160): Distance between the commissures of the mouth more than 2 SD below the mean. Alternatively, an apparently decreased width of the oral aperture (subjective). Evidence: TAS. Frequency: Occasional (HP:0040283). (ORPHA:357001)
- High palate (HP:0000218): Height of the palate more than 2 SD above the mean (objective) or palatal height at the level of the first permanent molar more than twice the height of the teeth (subjective). Evidence: TAS. Frequency: Occasional (HP:0040283). (ORPHA:357001)
- Thin upper lip vermilion (HP:0000219): Height of the vermilion of the upper lip in the midline more than 2 SD below the mean. Alternatively, an apparently reduced height of the vermilion of the upper lip in the frontal view (subjective). Evidence: TAS. Frequency: Occasional (HP:0040283). (ORPHA:357001)
- Brachycephaly (HP:0000248): An abnormality of skull shape characterized by a decreased anterior-posterior diameter. That is, a cephalic index greater than 81%. Alternatively, an apparently shortened anteroposterior dimension (length) of the head compared to width. Evidence: TAS. Frequency: Occasional (HP:0040283). (ORPHA:357001)
- Dolichocephaly (HP:0000268): An abnormality of skull shape characterized by a increased anterior-posterior diameter, i.e., an increased antero-posterior dimension of the skull. Cephalic index less than 76%. Alternatively, an apparently increased antero-posterior length of the head compared to width. Often due to premature closure of the sagittal suture. Evidence: TAS. Frequency: Occasional (HP:0040283). (ORPHA:357001)
- Malar flattening (HP:0000272): Underdevelopment of the malar prominence of the jugal bone (zygomatic bone in mammals), appreciated in profile, frontal view, and/or by palpation. Evidence: TAS. Frequency: Occasional (HP:0040283). (ORPHA:357001)
- Epicanthus (HP:0000286): A fold of skin starting above the medial aspect of the upper eyelid and arching downward to cover, pass in front of and lateral to the medial canthus. Evidence: TAS. Frequency: Occasional (HP:0040283). (ORPHA:357001)
- Hypertelorism (HP:0000316): Interpupillary distance more than 2 SD above the mean (alternatively, the appearance of an increased interpupillary distance or widely spaced eyes). Evidence: TAS. Frequency: Occasional (HP:0040283). (ORPHA:357001)
- Smooth philtrum (HP:0000319): Flat skin surface, with no ridge formation in the central region of the upper lip between the nasal base and upper vermilion border. Evidence: TAS. Frequency: Occasional (HP:0040283). (ORPHA:357001)
- Low-set ears (HP:0000369): Upper insertion of the ear to the scalp below an imaginary horizontal line drawn between the inner canthi of the eye and extending posteriorly to the ear. Evidence: TAS. Frequency: Occasional (HP:0040283). (ORPHA:357001)
- Macrotia (HP:0000400): Median longitudinal ear length greater than two standard deviations above the mean and median ear width greater than two standard deviations above the mean (objective); or, apparent increase in length and width of the pinna (subjective). Evidence: TAS. Frequency: Occasional (HP:0040283). (ORPHA:357001)
- Deeply set eye (HP:0000490): An eye that is more deeply recessed into the plane of the face than is typical. Evidence: TAS. Frequency: Occasional (HP:0040283). (ORPHA:357001)
- Long eyelashes (HP:0000527): Mid upper eyelash length >10 mm or increased length of the eyelashes (subjective). Evidence: TAS. Frequency: Occasional (HP:0040283). (ORPHA:357001)
- Optic nerve hypoplasia (HP:0000609): Underdevelopment of the optic nerve. Evidence: TAS. Frequency: Occasional (HP:0040283). (ORPHA:357001)
- Nystagmus (HP:0000639): Rhythmic, involuntary oscillations of one or both eyes related to abnormality in fixation, conjugate gaze, or vestibular mechanisms. Evidence: TAS. Frequency: Occasional (HP:0040283). (ORPHA:357001)
- Optic atrophy (HP:0000648): Atrophy of the optic nerve. Optic atrophy results from the death of the retinal ganglion cell axons that comprise the optic nerve and manifesting as a pale optic nerve on fundoscopy. Evidence: TAS. Frequency: Occasional (HP:0040283). (ORPHA:357001)
- Cafe-au-lait spot (HP:0000957): Cafe-au-lait spots are hyperpigmented lesions that can vary in color from light brown to dark brown with smooth borders and having a size of 1.5 cm or more in adults and 0.5 cm or more in children. Evidence: TAS. Frequency: Occasional (HP:0040283). (ORPHA:357001)
- Seizure (HP:0001250): A seizure is an intermittent abnormality of nervous system physiology characterized by a transient occurrence of signs and/or symptoms due to abnormal excessive or synchronous neuronal activity in the brain. Evidence: TAS. Frequency: Occasional (HP:0040283). (ORPHA:357001)
- Pes planus (HP:0001763): A foot where the longitudinal arch of the foot is in contact with the ground or floor when the individual is standing; or, in a patient lying supine, a foot where the arch is in contact with the surface of a flat board pressed against the sole of the foot by the examiner with a pressure similar to that expected from weight bearing; or, the height of the arch is reduced. Evidence: TAS. Frequency: Occasional (HP:0040283). (ORPHA:357001)
- Sandal gap (HP:0001852): A widely spaced gap between the first toe (the great toe) and the second toe. Evidence: TAS. Frequency: Occasional (HP:0040283). (ORPHA:357001)
- Deep plantar creases (HP:0001869): The presence of unusually deep creases (ridges/wrinkles) on the skin of sole of foot. Evidence: TAS. Frequency: Occasional (HP:0040283). (ORPHA:357001)
- Vomiting (HP:0002013): Forceful ejection of the contents of the stomach through the mouth by means of a series of involuntary spasmic contractions. Evidence: TAS. Frequency: Occasional (HP:0040283). (ORPHA:357001)
- Diarrhea (HP:0002014): Abnormally increased frequency (usually defined as three or more) loose or watery bowel movements a day. Evidence: TAS. Frequency: Occasional (HP:0040283). (ORPHA:357001)
- Abdominal pain (HP:0002027): An unpleasant sensation characterized by physical discomfort (such as pricking, throbbing, or aching) and perceived to originate in the abdomen. Evidence: TAS. Frequency: Occasional (HP:0040283). (ORPHA:357001)
- Short nose (HP:0003196): Distance from nasion to subnasale more than two standard deviations below the mean, or alternatively, an apparently decreased length from the nasal root to the nasal tip. Evidence: TAS. Frequency: Occasional (HP:0040283). (ORPHA:357001)
- Syringomyelia (HP:0003396): Dilated, glial-lined cavity in spinal cord. This cavity does not communicate with the central canal, and usually is between the dorsal columns unilaterally or bilaterally along the side of the cord. Evidence: TAS. Frequency: Occasional (HP:0040283). (ORPHA:357001)
- Depressed nasal bridge (HP:0005280): Posterior positioning of the nasal root in relation to the overall facial profile for age. Evidence: TAS. Frequency: Occasional (HP:0040283). (ORPHA:357001)
- Chiari type I malformation (HP:0007099): Arnold-Chiari type I malformation refers to a relatively mild degree of herniation of the posteroinferior region of the cerebellum (the cerebellar tonsils) into the cervical canal with little or no displacement of the fourth ventricle. It is characterized by one or both pointed (not rounded) cerebellar tonsils that project 5 mm below the foramen magnum, measured by a line drawn from the basion to the opisthion (McRae Line). Evidence: TAS. Frequency: Occasional (HP:0040283). (ORPHA:357001)
- Hypoplasia of the frontal lobes (HP:0007333): Underdevelopment of the frontal lobe of the cerebrum. Evidence: TAS. Frequency: Occasional (HP:0040283). (ORPHA:357001)
- Corpus callosum atrophy (HP:0007371): The presence of atrophy (wasting) of the corpus callosum. Evidence: TAS. Frequency: Occasional (HP:0040283). (ORPHA:357001)
- Increased nuchal translucency (HP:0010880): Nuchal translucency is the sonographic appearance of subcutaneous accumulation of liquid in the back of the fetal neck in the first trimester of pregnancy (11-14 gestational weeks of pregnancy). Evidence: TAS. Frequency: Occasional (HP:0040283). (ORPHA:357001)
- Feeding difficulties (HP:0011968): Impaired ability to eat related to problems gathering food and getting ready to suck, chew, or swallow it. Evidence: TAS. Frequency: Occasional (HP:0040283). (ORPHA:357001)
- Clinodactyly (HP:0030084): An angulation of a digit at an interphalangeal joint in the plane of the palm (finger) or sole (toe). Evidence: TAS. Frequency: Occasional (HP:0040283). (ORPHA:357001)
- Long fingers (HP:0100807): The middle finger is more than 2 SD above the mean for newborns 27 to 41 weeks EGA or above the 97th centile for children from birth to 16 years of age AND the five digits retain their normal length proportions relative to each other (i.e., it is not the case that the middle finger is the only lengthened digit), or, Fingers that appear disproportionately long compared to the palm of the hand. Evidence: TAS. Frequency: Occasional (HP:0040283). (ORPHA:357001)
These phenotypes are associated with the disease 19p13.13 microdeletion syndrome (ORPHA:357001).